Phenotypes associated with the disease Female infertility due to oocyte meiotic arrest (ORPHA:488191, an Orphanet rare-disease identifier):
- Female infertility (HP:0008222, a Human Phenotype Ontology term). Evidence: TAS. Frequency: Obligate (HP:0040280, a Human Phenotype Ontology term). (ORPHA:488191)
- Abnormal meiosis (HP:0031515, a Human Phenotype Ontology term): Any anomaly of meiosis, a type of cell division that reduces the number of chromosomes in the parent cell by half and produces four gamete cells. Evidence: TAS. Frequency: Obligate (HP:0040280, a Human Phenotype Ontology term). (ORPHA:488191)
- Metaphase I oocyte maturation arrest (HP:0031516, a Human Phenotype Ontology term): Failure of oocytes to proceed through the stages of meiosis with stoppage at the first metaphase stage. Evidence: TAS. Frequency: Frequent (HP:0040282, a Human Phenotype Ontology term). (ORPHA:488191)
- Abnormal oocyte morphology (HP:0020155, a Human Phenotype Ontology term): An abnormal structure of the female germ cell (egg cell). Evidence: TAS. Frequency: Occasional (HP:0040283, a Human Phenotype Ontology term). (ORPHA:488191)
Not associated with this disease:
- Polycystic ovaries (HP:0000147, a Human Phenotype Ontology term). Evidence: TAS. (ORPHA:488191)
- Abnormal spermatogenesis (HP:0008669, a Human Phenotype Ontology term): Incomplete maturation or aberrant formation of the male gametes. Evidence: TAS. (ORPHA:488191)